- Abnormality of the dentition (HP:0000164): Any abnormality of the teeth. Evidence: TAS. Frequency: Frequent (HP:0040282). (ORPHA:2889)
- Hearing impairment (HP:0000365): A decreased magnitude of the sensory perception of sound. Evidence: TAS. Frequency: Occasional (HP:0040283). (ORPHA:2889)
- Abnormal eyebrow morphology (HP:0000534): An abnormality of the eyebrow. Evidence: TAS. Frequency: Frequent (HP:0040282). (ORPHA:2889)
- Abnormal dental enamel morphology (HP:0000682): An abnormality of the dental enamel. Evidence: TAS. Frequency: Frequent (HP:0040282). (ORPHA:2889)
- Alopecia (HP:0001596): A noncongenital process of hair loss, which may progress to partial or complete baldness. Evidence: TAS. Frequency: Frequent (HP:0040282). (ORPHA:2889)
- Abnormal nail morphology (HP:0001597): Abnormal structure or appearance of the nail. Evidence: TAS. Frequency: Frequent (HP:0040282). (ORPHA:2889)
- Brittle hair (HP:0002299): Fragile, easily breakable hair, i.e., with reduced tensile strength. Evidence: TAS. Frequency: Frequent (HP:0040282). (ORPHA:2889)
- Pili torti (HP:0003777): Pili (from Latin pilus, hair) torti (from Latin tortus, twisted) refers to short and brittle hairs that appear flattened and twisted when viewed through a microscope. Evidence: TAS. Frequency: Very frequent (HP:0040281). (ORPHA:2889)
- Abnormality of hair texture (HP:0010719): An abnormality of the texture of the hair. Evidence: TAS. Frequency: Very frequent (HP:0040281). (ORPHA:2889)
These phenotypes are associated with the disease Pili torti (ORPHA:2889).